Phenotypes associated with the disease Microcephaly-cardiomyopathy syndrome (ORPHA:2515):
- Microcephaly (HP:0000252): Head circumference below 2 standard deviations below the mean for age and gender. Evidence: TAS. Frequency: Very frequent (HP:0040281). (ORPHA:2515)
- Intellectual disability (HP:0001249): The term intellectual disability or intellectual developmental disorder is used to describe significantly sub-average intellectual and adaptive functioning based on clinical assessment and as measured by individually administered, appropriately normed, standardized and validated tests of intellectual functioning and adaptive behavior, with onset during the developmental period from infancy through adolescence. Evidence: TAS. Frequency: Very frequent (HP:0040281). (ORPHA:2515)
- Dilated cardiomyopathy (HP:0001644): Dilated cardiomyopathy (DCM) is defined by the presence of left ventricular dilatation and left ventricular systolic dysfunction in the absence of abnormal loading conditions (hypertension, valve disease) or coronary artery disease sufficient to cause global systolic impairment. Right ventricular dilation and dysfunction may be present but are not necessary for the diagnosis. Evidence: TAS. Frequency: Very frequent (HP:0040281). (ORPHA:2515)
- Cognitive impairment (HP:0100543): Abnormal cognition is characterized by deficits in thinking, reasoning, or remembering. Evidence: TAS. Frequency: Very frequent (HP:0040281). (ORPHA:2515)
- Abnormality of the outer ear (HP:0000356): An abnormality of the external ear. Evidence: TAS. Frequency: Frequent (HP:0040282). (ORPHA:2515)
- Sandal gap (HP:0001852): A widely spaced gap between the first toe (the great toe) and the second toe. Evidence: TAS. Frequency: Frequent (HP:0040282). (ORPHA:2515)
- Clinodactyly of the 5th finger (HP:0004209): Clinodactyly refers to a bending or curvature of the fifth finger in the radial direction (i.e., towards the 4th finger). Evidence: TAS. Frequency: Frequent (HP:0040282). (ORPHA:2515)
- Short stature (HP:0004322): A height below that which is expected according to age and gender norms. Although there is no universally accepted definition of short stature, many refer to "short stature" as height more than 2 standard deviations below the mean for age and gender (or below the 3rd percentile for age and gender dependent norms). Evidence: TAS. Frequency: Frequent (HP:0040282). (ORPHA:2515)
- Sloping forehead (HP:0000340): Inclination of the anterior surface of the forehead from the vertical more than two standard deviations above the mean (objective); or apparently excessive posterior sloping of the forehead in a lateral view. Evidence: TAS. Frequency: Occasional (HP:0040283). (ORPHA:2515)
- Seizure (HP:0001250): A seizure is an intermittent abnormality of nervous system physiology characterized by a transient occurrence of signs and/or symptoms due to abnormal excessive or synchronous neuronal activity in the brain. Evidence: TAS. Frequency: Occasional (HP:0040283). (ORPHA:2515)
- Intrauterine growth retardation (HP:0001511): An abnormal restriction of fetal growth with fetal weight below the tenth percentile for gestational age. Evidence: TAS. Frequency: Occasional (HP:0040283). (ORPHA:2515)
- Ventricular septal defect (HP:0001629): A hole between the two bottom chambers (ventricles) of the heart. The defect is centered around the most superior aspect of the ventricular septum. Evidence: TAS. Frequency: Occasional (HP:0040283). (ORPHA:2515)
- Ventriculomegaly (HP:0002119): An increase in size of the ventricular system of the brain. Evidence: TAS. Frequency: Occasional (HP:0040283). (ORPHA:2515)
- High, narrow palate (HP:0002705): The presence of a high and narrow palate. Evidence: TAS. Frequency: Occasional (HP:0040283). (ORPHA:2515)
- Abnormal retinal pigmentation (HP:0007703): Any deviation from the normal pigmentation of the retina. Evidence: TAS. Frequency: Occasional (HP:0040283). (ORPHA:2515)